Phenotypes associated with the disease Acral self-healing collodion baby (ORPHA:281127, an Orphanet rare-disease identifier):
- Edema of the dorsum of hands (HP:0007514, a Human Phenotype Ontology term): An abnormal accumulation of fluid beneath the skin on the back of the hands. Evidence: TAS. Frequency: Very frequent (HP:0040281, a Human Phenotype Ontology term). (ORPHA:281127)
- Localized epidermolytic hyperkeratosis (HP:0007559, a Human Phenotype Ontology term). Evidence: TAS. Frequency: Very frequent (HP:0040281, a Human Phenotype Ontology term). (ORPHA:281127)
- Erythema (HP:0010783, a Human Phenotype Ontology term): Redness of the skin, caused by hyperemia of the capillaries in the lower layers of the skin. Evidence: TAS. Frequency: Very frequent (HP:0040281, a Human Phenotype Ontology term). (ORPHA:281127)
- Edema of the dorsum of feet (HP:0012098, a Human Phenotype Ontology term): An abnormal accumulation of fluid beneath the skin on the back of the feet. Evidence: TAS. Frequency: Very frequent (HP:0040281, a Human Phenotype Ontology term). (ORPHA:281127)
- Palmoplantar scaling skin (HP:0025524, a Human Phenotype Ontology term): Loss of the outer layer of the epidermis in large, scale-like flakes localized to the palm of the hand and the sole of the foot. Evidence: TAS. Frequency: Very frequent (HP:0040281, a Human Phenotype Ontology term). (ORPHA:281127)
- Lack of skin elasticity (HP:0100679, a Human Phenotype Ontology term). Evidence: TAS. Frequency: Very frequent (HP:0040281, a Human Phenotype Ontology term). (ORPHA:281127)